- Juvenile onset (HP:0003621): Onset of signs or symptoms of disease between the age of 5 and 15 years. Evidence: PCS. Frequency: 2/3. (PMID:21397062)
- Impaired renal tubular reabsorption of magnesium (HP:0033759): Decreased renal tubular reabsorption of magnesium. Evidence: PCS. Frequency: 2/2. (PMID:21397062)
- Vertigo (HP:0002321): An abnormal sensation of spinning while the body is actually stationary. Evidence: PCS. Frequency: 1/4. (PMID:21397062)
- Hypomagnesemia (HP:0002917): The concentration of magnesium in the blood circulation is below the lower limit of normal. Evidence: PCS. Frequency: 4/4. (PMID:21397062)
- Childhood onset (HP:0011463): Onset of disease at the age of between 1 and 5 years. Evidence: PCS. Frequency: 1/3. (PMID:21397062)
- Muscle weakness (HP:0001324): Reduced strength of muscles. Evidence: PCS. Frequency: 1/4. (PMID:21397062)
- Headache (HP:0002315): Cephalgia, or pain sensed in various parts of the head, not confined to the area of distribution of any nerve. Evidence: PCS. Frequency: 1/4. (PMID:21397062)
- Autosomal dominant inheritance (HP:0000006): A mode of inheritance that is observed for traits related to a gene encoded on one of the autosomes (i.e., the human chromosomes 1-22) in which a trait manifests in heterozygotes. In the context of medical genetics, an autosomal dominant disorder is caused when a single copy of the mutant allele is present. Males and females are affected equally, and can both transmit the disorder with a risk of 50% for each child of inheriting the mutant allele. Evidence: PCS. (PMID:21397062)
These phenotypes are associated with the disease renal hypomagnesemia 6 (OMIM:613882).